- Abnormality of the dentition (HP:0000164): Any abnormality of the teeth. Evidence: TAS. Frequency: Frequent (HP:0040282). (ORPHA:3241)
- Abnormal palate morphology (HP:0000174): Any abnormality of the palate, i.e., of roof of the mouth. Evidence: TAS. Frequency: Very frequent (HP:0040281). (ORPHA:3241)
- Short lingual frenulum (HP:0000200): The presence of an abnormally short lingual frenulum. Evidence: TAS. Frequency: Very frequent (HP:0040281). (ORPHA:3241)
- Short philtrum (HP:0000322): Distance between nasal base and midline upper lip vermilion border more than 2 SD below the mean. Alternatively, an apparently decreased distance between nasal base and midline upper lip vermilion border. Evidence: TAS. Frequency: Frequent (HP:0040282). (ORPHA:3241)
- Facial asymmetry (HP:0000324): An abnormal difference between the left and right sides of the face. Evidence: TAS. Frequency: Very frequent (HP:0040281). (ORPHA:3241)
- Sensorineural hearing impairment (HP:0000407): A type of hearing impairment in one or both ears related to an abnormal functionality of the cochlear nerve. Evidence: TAS. Frequency: Very frequent (HP:0040281). (ORPHA:3241)
- Underdeveloped nasal alae (HP:0000430): Thinned, deficient, or excessively arched ala nasi. Evidence: TAS. Frequency: Very frequent (HP:0040281). (ORPHA:3241)
- Wide nasal bridge (HP:0000431): Increased breadth of the nasal bridge (and with it, the nasal root). Evidence: TAS. Frequency: Very frequent (HP:0040281). (ORPHA:3241)
- Deeply set eye (HP:0000490): An eye that is more deeply recessed into the plane of the face than is typical. Evidence: TAS. Frequency: Frequent (HP:0040282). (ORPHA:3241)
- Upslanted palpebral fissure (HP:0000582): The palpebral fissure inclination is more than two standard deviations above the mean for age (objective); or, the inclination of the palpebral fissure is greater than typical for age. Evidence: TAS. Frequency: Frequent (HP:0040282). (ORPHA:3241)
- Patent ductus arteriosus (HP:0001643): In utero, the ductus arteriosus (DA) serves to divert ventricular output away from the lungs and toward the placenta by connecting the main pulmonary artery to the descending aorta. A patent ductus arteriosus (PDA) in the first 3 days of life is a physiologic shunt in healthy term and preterm newborn infants, and normally is substantially closed within about 24 hours after bith and completely closed after about three weeks. Failure of physiologcal closure is referred to a persistent or patent ductus arteriosus (PDA). Depending on the degree of left-to-right shunting, PDA can have clinical consequences. Evidence: TAS. Frequency: Frequent (HP:0040282). (ORPHA:3241)
- Frontal bossing (HP:0002007): Bilateral bulging of the lateral frontal bone prominences with relative sparing of the midline. Evidence: TAS. Frequency: Very frequent (HP:0040281). (ORPHA:3241)
- Temporal hypotrichosis (HP:0004524): Reduced or lacking hair growth in the temporal region (i.e., around the temples on the side of the skull). Evidence: TAS. Frequency: Very frequent (HP:0040281). (ORPHA:3241)
- Bifid tongue (HP:0010297): Tongue with a median apical indentation or fork. Evidence: TAS. Frequency: Very frequent (HP:0040281). (ORPHA:3241)
These phenotypes are associated with the disease Deafness-craniofacial syndrome (ORPHA:3241).